Phenotypes associated with the disease Monophalangy of great toe (OMIM:158100):
- Abnormality of the skeletal system (HP:0000924): An abnormality of the skeletal system. Evidence: IEA. (OMIM:158100)
- Autosomal dominant inheritance (HP:0000006): A mode of inheritance that is observed for traits related to a gene encoded on one of the autosomes (i.e., the human chromosomes 1-22) in which a trait manifests in heterozygotes. In the context of medical genetics, an autosomal dominant disorder is caused when a single copy of the mutant allele is present. Males and females are affected equally, and can both transmit the disorder with a risk of 50% for each child of inheriting the mutant allele. Evidence: IEA. (OMIM:158100)